Phenotypes associated with the disease Microphthalmia with brain and digit anomalies (ORPHA:139471):
- Cryptorchidism (HP:0000028): Testis in inguinal canal. That is, absence of one or both testes from the scrotum owing to failure of the testis or testes to descend through the inguinal canal to the scrotum. Evidence: TAS. Frequency: Occasional (HP:0040283). (ORPHA:139471)
- High palate (HP:0000218): Height of the palate more than 2 SD above the mean (objective) or palatal height at the level of the first permanent molar more than twice the height of the teeth (subjective). Evidence: TAS. Frequency: Occasional (HP:0040283). (ORPHA:139471)
- Microcephaly (HP:0000252): Head circumference below 2 standard deviations below the mean for age and gender. Evidence: TAS. Frequency: Occasional (HP:0040283). (ORPHA:139471)
- Sensorineural hearing impairment (HP:0000407): A type of hearing impairment in one or both ears related to an abnormal functionality of the cochlear nerve. Evidence: TAS. Frequency: Occasional (HP:0040283). (ORPHA:139471)
- Microcornea (HP:0000482): A congenital abnormality of the cornea in which the cornea and the anterior segment of the eye are smaller than normal. The horizontal diameter of the cornea does not reach 10 mm even in adulthood. Evidence: TAS. Frequency: Frequent (HP:0040282). (ORPHA:139471)
- Cataract (HP:0000518): A cataract is an opacity or clouding that develops in the crystalline lens of the eye or in its capsule. Evidence: TAS. Frequency: Frequent (HP:0040282). (ORPHA:139471)
- Anophthalmia (HP:0000528): Absence of the globe or eyeball. Evidence: TAS. Frequency: Very frequent (HP:0040281). (ORPHA:139471)
- Myopia (HP:0000545): An abnormality of refraction characterized by the ability to see objects nearby clearly, while objects in the distance appear blurry. Evidence: TAS. Frequency: Occasional (HP:0040283). (ORPHA:139471)
- Retinal dystrophy (HP:0000556): Retinal dystrophy is an abnormality of the retina associated with a hereditary process. Retinal dystrophies are defined by their predominantly monogenic inheritance and they are frequently associated with loss or dysfunction of photoreceptor cells as a primary or secondary event. Evidence: TAS. Frequency: Occasional (HP:0040283). (ORPHA:139471)
- Chorioretinal coloboma (HP:0000567): Absence of a region of the retina, retinal pigment epithelium, and choroid. Evidence: TAS. Frequency: Frequent (HP:0040282). (ORPHA:139471)
- Microphthalmia (HP:0000568): A developmental anomaly characterized by abnormal smallness of one or both eyes. Evidence: TAS. Frequency: Very frequent (HP:0040281). (ORPHA:139471)
- Iris coloboma (HP:0000612): A coloboma of the iris. Evidence: TAS. Frequency: Frequent (HP:0040282). (ORPHA:139471)
- Nystagmus (HP:0000639): Rhythmic, involuntary oscillations of one or both eyes related to abnormality in fixation, conjugate gaze, or vestibular mechanisms. Evidence: TAS. Frequency: Occasional (HP:0040283). (ORPHA:139471)
- Sclerocornea (HP:0000647): A congenital anomaly in which a part or the whole of the cornea acquires the characteristics of sclera, resulting in clouding of the cornea. Evidence: TAS. Frequency: Occasional (HP:0040283). (ORPHA:139471)
- Abnormality of the hypothalamus-pituitary axis (HP:0000864): Abnormality of the pituitary gland (also known as hypophysis), which is an endocrine gland that protrudes from the bottom of the hypothalamus at the base of the brain. The pituitary gland secretes the hormones ACTH, TSH, PRL, GH, endorphins, FSH, LH, oxytocin, and antidiuretic hormone. The secretion of hormones from the anterior pituitary is under the strict control of hypothalamic hormones, and the posterior pituitary is essentially an extension of the hypothalamus, so that hypothalamus and pituitary gland may be regarded as a functional unit. Evidence: TAS. Frequency: Occasional (HP:0040283). (ORPHA:139471)
- Seizure (HP:0001250): A seizure is an intermittent abnormality of nervous system physiology characterized by a transient occurrence of signs and/or symptoms due to abnormal excessive or synchronous neuronal activity in the brain. Evidence: TAS. Frequency: Occasional (HP:0040283). (ORPHA:139471)
- Global developmental delay (HP:0001263): A delay in the achievement of motor or mental milestones in the domains of development of a child, including motor skills, speech and language, cognitive skills, and social and emotional skills. This term should only be used to describe children younger than five years of age. Evidence: TAS. Frequency: Frequent (HP:0040282). (ORPHA:139471)
- Agenesis of corpus callosum (HP:0001274): Absence of the corpus callosum as a result of the failure of the corpus callosum to develop, which can be the result of a failure in any one of the multiple steps of callosal development including cellular proliferation and migration, axonal growth or glial patterning at the midline. Evidence: TAS. Frequency: Occasional (HP:0040283). (ORPHA:139471)
- Postaxial foot polydactyly (HP:0001830): Polydactyly of the foot most commonly refers to the presence of six toes on one foot. Postaxial polydactyly affects the lateral ray and the duplication may range from a well-formed articulated digit to a rudimentary digit. Evidence: TAS. Frequency: Occasional (HP:0040283). (ORPHA:139471)
- Nail dysplasia (HP:0002164): The presence of developmental dysplasia of the nail. Evidence: TAS. Frequency: Occasional (HP:0040283). (ORPHA:139471)
- Finger syndactyly (HP:0006101): Webbing or fusion of the fingers, involving soft parts only or including bone structure. Bony fusions are referred to as "bony" Syndactyly if the fusion occurs in a radio-ulnar axis. Fusions of bones of the fingers in a proximo-distal axis are referred to as "Symphalangism". Evidence: TAS. Frequency: Occasional (HP:0040283). (ORPHA:139471)
- Inferior cerebellar vermis hypoplasia (HP:0007068): Underdevelopment of the inferior portion of the vermis of cerebellum. Evidence: TAS. Frequency: Occasional (HP:0040283). (ORPHA:139471)
- Proximal placement of thumb (HP:0009623): Proximal mislocalization of the thumb. Evidence: TAS. Frequency: Occasional (HP:0040283). (ORPHA:139471)